Phenotypes associated with the disease Postinfectious vasculitis (ORPHA:48435):
- Glomerulonephritis (HP:0000099): Inflammation of the renal glomeruli. Evidence: TAS. Frequency: Frequent (HP:0040282). (ORPHA:48435)
- Weight loss (HP:0001824): Reduction of total body weight. Evidence: TAS. Frequency: Frequent (HP:0040282). (ORPHA:48435)
- Fever (HP:0001945): Body temperature elevated above the normal range. Evidence: TAS. Frequency: Frequent (HP:0040282). (ORPHA:48435)
- Anorexia (HP:0002039): Lack of desire to eat (loss of appetite). Evidence: TAS. Frequency: Frequent (HP:0040282). (ORPHA:48435)
- Arthralgia (HP:0002829): Joint pain. Evidence: TAS. Frequency: Frequent (HP:0040282). (ORPHA:48435)
- Myalgia (HP:0003326): Pain in muscle. Evidence: TAS. Frequency: Frequent (HP:0040282). (ORPHA:48435)
- Abnormality of humoral immunity (HP:0005368): An abnormality of the humoral immune system, which comprises antibodies produced by B cells as well as the complement system. Evidence: TAS. Frequency: Frequent (HP:0040282). (ORPHA:48435)
- Abnormal circulating protein concentration (HP:0010876): An abnormal level of a circulating protein in the blood. Evidence: TAS. Frequency: Frequent (HP:0040282). (ORPHA:48435)
- Inflammatory abnormality of the skin (HP:0011123): The presence of inflammation of the skin. That is, an abnormality of the skin resulting from the local accumulation of fluid, plasma proteins, and leukocytes. Evidence: TAS. Frequency: Frequent (HP:0040282). (ORPHA:48435)
- Elevated circulating C-reactive protein concentration (HP:0011227): The concentration of C-reactive protein in the blood circulation is above the upper limit of normal. Evidence: TAS. Frequency: Frequent (HP:0040282). (ORPHA:48435)
- Increased inflammatory response (HP:0012649): A abnormal increase in the inflammatory response to injury or infection. Evidence: TAS. Frequency: Frequent (HP:0040282). (ORPHA:48435)
- Night sweats (HP:0030166): Occurrence of excessive sweating during sleep. Evidence: TAS. Frequency: Frequent (HP:0040282). (ORPHA:48435)
- Severe viral infection (HP:0031691): An unusually severe viral infection. Evidence: TAS. Frequency: Frequent (HP:0040282). (ORPHA:48435)
- Multiple mononeuropathy (HP:0032018): A type of peripheral neuropathy that happens when there is damage to two or more different nerve areas characterized by peripheral neuropathy of both the motor and sensory nerves of at least two different nerve trunks. Different nerves are affected either simultaneously or sequentially. Evidence: TAS. Frequency: Frequent (HP:0040282). (ORPHA:48435)
- Vasculitis in the skin (HP:0200029): A type of vasculitis (inflammation of blood vessel walls) that affects skeletal muscle tissue. Evidence: TAS. Frequency: Frequent (HP:0040282). (ORPHA:48435)
- Abnormality of the peripheral nervous system (HP:0410008): Any abnormality of the part of the nervous system that consists of the nerves and ganglia outside of the brain and spinal cord. Evidence: TAS. Frequency: Frequent (HP:0040282). (ORPHA:48435)
- Proteinuria (HP:0000093): Increased levels of protein in the urine. Evidence: TAS. Frequency: Occasional (HP:0040283). (ORPHA:48435)
- Hematuria (HP:0000790): The presence of blood in the urine. Hematuria may be gross hematuria (visible to the naked eye) or microscopic hematuria (detected by dipstick or microscopic examination of the urine). Evidence: TAS. Frequency: Occasional (HP:0040283). (ORPHA:48435)
- Membranoproliferative glomerulonephritis (HP:0000793): A type of glomerulonephritis characterized by diffuse mesangial cell proliferation and the thickening of capillary walls due to subendothelial extension of the mesangium. The term membranoproliferative glomerulonephritis is often employed to denote a general pattern of glomerular injury seen in a variety of disease processes that share a common pathogenetic mechanism, rather than to describe a single disease entity. Evidence: TAS. Frequency: Occasional (HP:0040283). (ORPHA:48435)
- Hypertension (HP:0000822): The presence of chronic increased pressure in the systemic arterial system. Evidence: TAS. Frequency: Occasional (HP:0040283). (ORPHA:48435)
- Cutis marmorata (HP:0000965): A reticular discoloration of the skin with cyanotic (reddish-blue appearing) areas surrounding pale central areas due to dilation of capillary blood vessels and stagnation of blood within the vessels. Cutis marmorata generally occurs on the legs, arms and trunk and is often more severe in cold weather. Evidence: TAS. Frequency: Occasional (HP:0040283). (ORPHA:48435)
- Acrocyanosis (HP:0001063): Bluish discoloration of the skin of the hands or feet. Evidence: TAS. Frequency: Occasional (HP:0040283). (ORPHA:48435)
- Arthritis (HP:0001369): Inflammation of a joint. Evidence: TAS. Frequency: Occasional (HP:0040283). (ORPHA:48435)
- Subcutaneous nodule (HP:0001482): Slightly elevated lesions on or in the skin with a diameter of over 5 mm. Evidence: TAS. Frequency: Occasional (HP:0040283). (ORPHA:48435)
- Cardiomyopathy (HP:0001638): A myocardial disorder in which the heart muscle is structurally and functionally abnormal, in the absence of coronary artery disease, hypertension, valvular disease and congenital heart disease sufficient to cause the observed myocardial abnormality. Evidence: TAS. Frequency: Occasional (HP:0040283). (ORPHA:48435)
- Morphological central nervous system abnormality (HP:0002011): A structural abnormality of the central nervous system. Evidence: TAS. Frequency: Occasional (HP:0040283). (ORPHA:48435)
- Abdominal pain (HP:0002027): An unpleasant sensation characterized by physical discomfort (such as pricking, throbbing, or aching) and perceived to originate in the abdomen. Evidence: TAS. Frequency: Occasional (HP:0040283). (ORPHA:48435)
- Pneumonia (HP:0002090): Inflammation of any part of the lung parenchyma. Evidence: TAS. Frequency: Occasional (HP:0040283). (ORPHA:48435)
- Ischemic stroke (HP:0002140): Acute ischemic stroke (AIS) is defined by the sudden loss of blood flow to an area of the brain with the resulting loss of neurologic function. It is caused by thrombosis or embolism that occludes a cerebral vessel supplying a specific area of the brain. During a vessel occlusion, there is a core area where damage to the brain is irreversible and an area of penumbra where the brain has lost function owing to decreased blood flow but is not irreversibly injured. Evidence: TAS. Frequency: Occasional (HP:0040283). (ORPHA:48435)
- Vascular dilatation (HP:0002617): An abnormal increase in the diameter of an artery or vein, either as a diffuse dilatation or as a localized, sac-like outpouching of the vessel wall (aneurysm). Evidence: TAS. Frequency: Occasional (HP:0040283). (ORPHA:48435)
- Recurrent Staphylococcus aureus infection (HP:0002726): Increased susceptibility to Staphylococcus aureus infections as manifested by recurrent episodes of Staphylococcus aureus infection. Evidence: TAS. Frequency: Occasional (HP:0040283). (ORPHA:48435)
- Rheumatoid factor positive (HP:0002923): The presence in the serum of an autoantibody directed against the Fc portion of IgG. Evidence: TAS. Frequency: Occasional (HP:0040283). (ORPHA:48435)
- Increased circulating IgA concentration (HP:0003261): An abnormally increased level of immunoglobulin A in blood. Evidence: TAS. Frequency: Occasional (HP:0040283). (ORPHA:48435)
- Antinuclear antibody positivity (HP:0003493): The presence of autoantibodies in the serum that react against nuclei or nuclear components. Evidence: TAS. Frequency: Occasional (HP:0040283). (ORPHA:48435)
- Gastrointestinal inflammation (HP:0004386): Inflammation of the alimentary part of the gastrointestinal system. Evidence: TAS. Frequency: Occasional (HP:0040283). (ORPHA:48435)
- Cerebral vasculitis (HP:0005318): Inflammation of the blood vessels within the brain. Evidence: TAS. Frequency: Occasional (HP:0040283). (ORPHA:48435)
- Recurrent streptococcus pneumoniae infections (HP:0005366): Increased susceptibility to streptococcus pneumoniae infections as manifested by a history of recurrent infections by streptococcus pneumoniae. Evidence: TAS. Frequency: Occasional (HP:0040283). (ORPHA:48435)
- Recurrent Candida infection (HP:0005401): Increased susceptibility to Candida infections as manifested by recurrent episodes of Candida infection. Evidence: TAS. Frequency: Occasional (HP:0040283). (ORPHA:48435)
- Viral hepatitis (HP:0006562): Inflammation of the liver due to infection with a virus. Evidence: TAS. Frequency: Occasional (HP:0040283). (ORPHA:48435)
- Bacterial endocarditis (HP:0006689): A bacterial infection of the endocardium, the inner layer of the heart, which usually involves the heart valves. Evidence: TAS. Frequency: Occasional (HP:0040283). (ORPHA:48435)
- Peripheral neuropathy (HP:0009830): Peripheral neuropathy is a general term for any disorder of the peripheral nervous system. The main clinical features used to classify peripheral neuropathy are distribution, type (mainly demyelinating versus mainly axonal), duration, and course. Evidence: TAS. Frequency: Occasional (HP:0040283). (ORPHA:48435)
- Increased circulating immunoglobulin concentration (HP:0010702): An increased level of gamma globulin (immunoglobulin) in the blood. Evidence: TAS. Frequency: Occasional (HP:0040283). (ORPHA:48435)
- Recurrent mycobacterial infections (HP:0011274): Increased susceptibility to mycobacterial infections as manifested by recurrent episodes of mycobacterial infection. Evidence: TAS. Frequency: Occasional (HP:0040283). (ORPHA:48435)
- Invasive fungal infection (HP:0020101): Fungal infection characterized by invasion of host tissues. Evidence: TAS. Frequency: Occasional (HP:0040283). (ORPHA:48435)
- Persistent human papillomavirus infection (HP:0020114): Human papillomaviruses (HPVs) are small oncogenic viruses. HPV has been shown to cause a variety of lesions and malignancies, which predominantly affect the anogenital region. Low-risk, non-oncogenic HPV types are associated with anogenital warts and recurrent respiratory papillomatosis while high-risk, oncogenic types are associated with cervical, penile, anal, vaginal, vulvar, and oropharyngeal cancers. Infection with anogenital HPV is usually asymptomatic and resolves spontaneously without consequences in the immunocompetent host. When disease does occur, the most common manifestation is genital warts, which may be small papules, or flat, smooth or pedunculated lesions. This resolution of HPV lesions is not generally seen in the immunosuppressed, resulting in severe, persistent and extensive manifestations of HPV disease. Evidence: TAS. Frequency: Occasional (HP:0040283). (ORPHA:48435)
- Elevated circulating haptoglobin concentration (HP:0020180): The concentration of haptoglobin in the blood circulation is above the upper limit of normal. Evidence: TAS. Frequency: Occasional (HP:0040283). (ORPHA:48435)
- Chills (HP:0025143): A sudden sensation of feeling cold. Evidence: TAS. Frequency: Occasional (HP:0040283). (ORPHA:48435)
- Retinal vasculitis (HP:0025188): Inflammation of retinal blood vessels as manifested by perivascular sheathing or cuffing, vascular leakage and/or occlusion. It can affect veins, arteries or both. Evidence: TAS. Frequency: Occasional (HP:0040283). (ORPHA:48435)
- Raynaud phenomenon (HP:0030880). Evidence: TAS. Frequency: Occasional (HP:0040283). (ORPHA:48435)
- Palpable purpura (HP:0031363): A type of purpura in which the lesions are raised (and can therefore be appreciated upon palpation). Evidence: TAS. Frequency: Occasional (HP:0040283). (ORPHA:48435)
- Severe cytomegalovirus infection (HP:0031692): An unusually severe infection by cytomegalovirus. Evidence: TAS. Frequency: Occasional (HP:0040283). (ORPHA:48435)
- Severe Epstein Barr virus infection (HP:0031693): An unusually severe Epstein Barr virus (EBV) infection. Evidence: TAS. Frequency: Occasional (HP:0040283). (ORPHA:48435)
- Unusual gastrointestinal infection (HP:0032166). Evidence: TAS. Frequency: Occasional (HP:0040283). (ORPHA:48435)
- Severe varicella zoster infection (HP:0032170): An unusually severe form of varicella zoster virus (VZV) infection. In the majority of the cases, especially in children, varicella is a very mild infection characterized by skin lesions, low grade fever and malaise. Severe infection is characterized by manifestations including VZV pneumonia, hepatitis, meningitis, and disseminated varicella. Evidence: TAS. Frequency: Occasional (HP:0040283). (ORPHA:48435)
- Cytoplasmic antineutrophil antibody positivity (HP:0032230): The presence of autoantibodies in the serum that react against proteins predominantly expressed in cytoplasmic granules of neutrophils. Evidence: TAS. Frequency: Occasional (HP:0040283). (ORPHA:48435)
- Cryoglobulinemia (HP:0100778): Increased level of cryoglobulins in the blood. Cryoglobulins are abnormal immunoglobulins, especially IGG or IGM, that precipitate spontaneously when serum is cooled below 37 degrees Celsius. Evidence: TAS. Frequency: Occasional (HP:0040283). (ORPHA:48435)
- Orchitis (HP:0100796): Testicular inflammation. Evidence: TAS. Frequency: Occasional (HP:0040283). (ORPHA:48435)